- Pruritus (HP:0000989): Pruritus is an itch or a sensation that makes a person want to scratch. This term refers to an abnormally increased disposition to experience pruritus. Evidence: TAS. Frequency: Very frequent (HP:0040281). (ORPHA:1656)
- Urticaria (HP:0001025): Raised, well-circumscribed areas of erythema and edema involving the dermis and epidermis. Urticaria is intensely pruritic, and blanches completely with pressure. Evidence: TAS. Frequency: Very frequent (HP:0040281). (ORPHA:1656)
- Microcytic anemia (HP:0001935): A kind of anemia in which the volume of the red blood cells is reduced. Evidence: TAS. Frequency: Very frequent (HP:0040281). (ORPHA:1656)
- Malabsorption (HP:0002024): Impaired ability to absorb one or more nutrients from the intestine. Evidence: TAS. Frequency: Very frequent (HP:0040281). (ORPHA:1656)
- Recurrent fractures (HP:0002757): The repeated occurrence of bone fractures (implying an abnormally increased tendency for fracture). Evidence: TAS. Frequency: Very frequent (HP:0040281). (ORPHA:1656)
- Autoimmunity (HP:0002960): The occurrence of an immune reaction against the organism's own cells or tissues. Evidence: TAS. Frequency: Very frequent (HP:0040281). (ORPHA:1656)
- Abnormal blistering of the skin (HP:0008066): The presence of one or more bullae on the skin, defined as fluid-filled blisters more than 5 mm in diameter with thin walls. Evidence: TAS. Frequency: Very frequent (HP:0040281). (ORPHA:1656)
- Erythema (HP:0010783): Redness of the skin, caused by hyperemia of the capillaries in the lower layers of the skin. Evidence: TAS. Frequency: Very frequent (HP:0040281). (ORPHA:1656)
- Gluten intolerance (HP:0012538): A detrimental reaction to the presence of gluten in food, which may include abdominal pain, fatigue, headaches and paresthesia, or celiac disease. Evidence: TAS. Frequency: Very frequent (HP:0040281). (ORPHA:1656)
- Macule (HP:0012733): A flat, distinct, discolored area of skin less than 1 cm wide that does not involve any change in the thickness or texture of the skin. Evidence: TAS. Frequency: Very frequent (HP:0040281). (ORPHA:1656)
- Skin vesicle (HP:0200037): A circumscribed, fluid-containing, epidermal elevation less than 10mm in diameter at the widest point that (i) Contain serous exudates or serum mixed with blood or pus; (ii) Are discrete, grouped, irregularly distributed, or linear as in Rhus dermatitis; (iii) Are short-lived. Vesicles may break spontaneously or evolve into bullae by enlarging or coalescing with other vesicles. Evidence: TAS. Frequency: Very frequent (HP:0040281). (ORPHA:1656)
- Eczematoid dermatitis (HP:0000964): Eczema is a form of dermatitis that is characterized by scaly, pruritic, erythematous lesions located on flexural surfaces. Evidence: TAS. Frequency: Frequent (HP:0040282). (ORPHA:1656)
- Anti-epidermal transglutaminase antibody positivity (HP:0033565): The presence of autoantibodies (immunoglobulins) in the blood circulation that react against epidermal transglutaminase. Evidence: TAS. Frequency: Frequent (HP:0040282). (ORPHA:1656)
- Anti-endomysial antibody positivity (HP:0033637): The presence of autoantibodies (immunoglobulins) in the blood circulation that react against endomysial tissue transglutaminase 2 (tTG2). Evidence: TAS. Frequency: Frequent (HP:0040282). (ORPHA:1656)
- Anti-transglutaminase 6 antibody (HP:4000026): The presence of autoantibodies (immunoglobulins) in the blood circulation that react against transglutaminase 6. Evidence: TAS. Frequency: Frequent (HP:0040282). (ORPHA:1656)
- Antigliadin antibody positivity (HP:4000029): The presence of autoantibodies (immunoglobulins) in the serum that react against gliadin. Evidence: TAS. Frequency: Frequent (HP:0040282). (ORPHA:1656)
- Anti-reticulin antibody positivity (HP:4000030): The presence of autoantibodies (immunoglobulins) in the serum that react against reticulin. Evidence: TAS. Frequency: Frequent (HP:0040282). (ORPHA:1656)
- Anti-type VII collagen antibody (HP:4000031): The presence of autoantibodies (immunoglobulins) in the serum that react against collagen type VII. Evidence: TAS. Frequency: Frequent (HP:0040282). (ORPHA:1656)
- Delayed eruption of teeth (HP:0000684): Delayed tooth eruption, which can be defined as tooth eruption more than 2 SD beyond the mean eruption age. Evidence: TAS. Frequency: Occasional (HP:0040283). (ORPHA:1656)
- Abnormality of the thyroid gland (HP:0000820): An abnormality of the thyroid gland. Evidence: TAS. Frequency: Occasional (HP:0040283). (ORPHA:1656)
- Edema (HP:0000969): An abnormal accumulation of fluid beneath the skin, or in one or more cavities of the body. Evidence: TAS. Frequency: Occasional (HP:0040283). (ORPHA:1656)
- Bone pain (HP:0002653): An unpleasant sensation characterized by physical discomfort (such as pricking, throbbing, or aching) localized to bone. Evidence: TAS. Frequency: Occasional (HP:0040283). (ORPHA:1656)
- Dental enamel pits (HP:0009722): The presence of small depressions in the dental enamel. Evidence: TAS. Frequency: Occasional (HP:0040283). (ORPHA:1656)
- Lichenification (HP:0100725): Thickening and hardening of the epidermis seen with exaggeration of normal skin lines. Evidence: TAS. Frequency: Occasional (HP:0040283). (ORPHA:1656)
- Abnormality of the nervous system (HP:0000707): An abnormality of the nervous system. Evidence: TAS. Frequency: Very rare (HP:0040284). (ORPHA:1656)
- Erosion of oral mucosa (HP:0031446): Loss of the superficial layer of the oral mucosa usually resulting in a shallow or crusted lesion. Evidence: TAS. Frequency: Very rare (HP:0040284). (ORPHA:1656)
These phenotypes are associated with the disease Dermatitis herpetiformis (ORPHA:1656).